- Weight loss (HP:0001824): Reduction of total body weight. Evidence: TAS. Frequency: Occasional (HP:0040283). (ORPHA:67)
- Diarrhea (HP:0002014): Abnormally increased frequency (usually defined as three or more) loose or watery bowel movements a day. Evidence: TAS. Frequency: Occasional (HP:0040283). (ORPHA:67)
- Abdominal pain (HP:0002027): An unpleasant sensation characterized by physical discomfort (such as pricking, throbbing, or aching) and perceived to originate in the abdomen. Evidence: TAS. Frequency: Occasional (HP:0040283). (ORPHA:67)
- Gastrointestinal dysmotility (HP:0002579): Abnormal intestinal contractions, such as spasms and intestinal paralysis, related to the loss of the ability of the gut to coordinate muscular activity because of endogenous or exogenous causes. Evidence: TAS. Frequency: Occasional (HP:0040283). (ORPHA:67)
- Protracted diarrhea (HP:0004385). Evidence: TAS. Frequency: Occasional (HP:0040283). (ORPHA:67)
- Bloody diarrhea (HP:0025085): Passage of many stools containing blood. Evidence: TAS. Frequency: Occasional (HP:0040283). (ORPHA:67)
- Chest pain (HP:0100749): An unpleasant sensation characterized by physical discomfort (such as pricking, throbbing, or aching) localized to the chest. Evidence: TAS. Frequency: Occasional (HP:0040283). (ORPHA:67)
- Congestive heart failure (HP:0001635): The presence of an abnormality of cardiac function that is responsible for the failure of the heart to pump blood at a rate that is commensurate with the needs of the tissues or a state in which abnormally elevated filling pressures are required for the heart to do so. Heart failure is frequently related to a defect in myocardial contraction. Evidence: TAS. Frequency: Very rare (HP:0040284). (ORPHA:67)
- Abnormal pericardium morphology (HP:0001697): An abnormality of the pericardium, i.e., of the fluid filled sac that surrounds the heart and the proximal ends of the aorta, vena cava, and the pulmonary artery. Evidence: TAS. Frequency: Very rare (HP:0040284). (ORPHA:67)
- Anemia (HP:0001903): A reduction in erythrocytes volume or hemoglobin concentration. Evidence: TAS. Frequency: Very rare (HP:0040284). (ORPHA:67)
- Fever (HP:0001945): Body temperature elevated above the normal range. Evidence: TAS. Frequency: Very rare (HP:0040284). (ORPHA:67)
- Increased total leukocyte count (HP:0001974): An abnormal increase in the number of leukocytes in the blood. Evidence: TAS. Frequency: Very rare (HP:0040284). (ORPHA:67)
- Dyspnea (HP:0002094): Difficult or labored breathing. Dyspnea is a subjective feeling only the patient can rate, e.g., on a Borg scale. Evidence: TAS. Frequency: Very rare (HP:0040284). (ORPHA:67)
- Hemoptysis (HP:0002105): Coughing up (expectoration) of blood or blood-streaked sputum from the larynx, trachea, bronchi, or lungs. Evidence: TAS. Frequency: Very rare (HP:0040284). (ORPHA:67)
- Pleural effusion (HP:0002202): The presence of an excessive amount of fluid in the pleural cavity. Evidence: TAS. Frequency: Very rare (HP:0040284). (ORPHA:67)
- Constrictive pericarditis (HP:0002563): Presence of a thickened, fibrotic pericardium that forms a non-compliant shell around the heart, and resulting from chronic inflammation of the pericardium. Evidence: TAS. Frequency: Very rare (HP:0040284). (ORPHA:67)
- Deep venous thrombosis (HP:0002625): Formation of a blot clot in a deep vein. The clot often blocks blood flow, causing swelling and pain. The deep veins of the leg are most often affected. Evidence: TAS. Frequency: Very rare (HP:0040284). (ORPHA:67)
- Elevated circulating hepatic transaminase concentration (HP:0002910): Elevations of the levels of SGOT and SGPT in the serum. SGOT (serum glutamic oxaloacetic transaminase) and SGPT (serum glutamic pyruvic transaminase) are transaminases primarily found in the liver and heart and are released into the bloodstream as the result of liver or heart damage. SGOT and SGPT are used clinically mainly as markers of liver damage. Evidence: TAS. Frequency: Very rare (HP:0040284). (ORPHA:67)
- Hypoalbuminemia (HP:0003073): The concentration of albumin in the blood circulation is below the lower limit of normal. Evidence: TAS. Frequency: Very rare (HP:0040284). (ORPHA:67)
- Elevated circulating alkaline phosphatase concentration (HP:0003155): Abnormally increased serum levels of alkaline phosphatase activity. Evidence: TAS. Frequency: Very rare (HP:0040284). (ORPHA:67)
- Intestinal obstruction (HP:0005214): Blockage or impairment of the normal flow of the contents of the intestine towards the anal canal. Evidence: TAS. Frequency: Very rare (HP:0040284). (ORPHA:67)
- Pleural empyema (HP:0011919): Accumulation of pus in the pleural cavity. Evidence: TAS. Frequency: Very rare (HP:0040284). (ORPHA:67)
- Cough (HP:0012735): A sudden, audible expulsion of air from the lungs through a partially closed glottis, preceded by inhalation. Evidence: TAS. Frequency: Very rare (HP:0040284). (ORPHA:67)
- Lung abscess (HP:0025044): A circumscribed area of pus or necrotic debris in lung parenchyma, which leads to a cavity, and after formation of bronchopulmonary fistula, can manifest as an air-fluid level inside the cavity. Evidence: TAS. Frequency: Very rare (HP:0040284). (ORPHA:67)
- Abnormal sputum (HP:0032016): Abnormal appearance of material expectorated (coughed up) from the respiratory system and that is composed of mucus but may contain other substances such as pus, blood, microorganisms, and fibrin. Evidence: TAS. Frequency: Very rare (HP:0040284). (ORPHA:67)
- Acute colitis (HP:0100282): An acute and self-limited inflammatory disease of the large intestine (colon, cecum and rectum). Evidence: TAS. Frequency: Very rare (HP:0040284). (ORPHA:67)
- Liver abscess (HP:0100523): A localized, circumscribed collection of purulent material (pus) within the liver parenchyma, typically resulting from a bacterial, parasitic, or fungal infection. Unlike hepatitis, which is often diffuse, an abscess is a focal lesion. Evidence: TAS. Frequency: Very rare (HP:0040284). (ORPHA:67)
These phenotypes are associated with the disease Amoebiasis due to Entamoeba histolytica (ORPHA:67).